Phenotypes associated with the disease cranioacrofacial syndrome (OMIM:122850):
- Narrow face (HP:0000275): Bizygomatic (upper face) and bigonial (lower face) width are both more than 2 standard deviations below the mean (objective); or, an apparent reduction in the width of the upper and lower face (subjective). Evidence: TAS. (OMIM:122850)
- Ventricular septal defect (HP:0001629): A hole between the two bottom chambers (ventricles) of the heart. The defect is centered around the most superior aspect of the ventricular septum. Evidence: IEA. (OMIM:122850)
- Pulmonic stenosis (HP:0001642): A narrowing of the right ventricular outflow tract that can occur at the pulmonary valve (valvular stenosis), below the pulmonary valve (infundibular stenosis), or above the pulmonary valve (supravalvar stenosis). Evidence: IEA. (OMIM:122850)
- Autosomal dominant inheritance (HP:0000006): A mode of inheritance that is observed for traits related to a gene encoded on one of the autosomes (i.e., the human chromosomes 1-22) in which a trait manifests in heterozygotes. In the context of medical genetics, an autosomal dominant disorder is caused when a single copy of the mutant allele is present. Males and females are affected equally, and can both transmit the disorder with a risk of 50% for each child of inheriting the mutant allele. Evidence: IEA. (OMIM:122850)
- Abnormal hand morphology (HP:0005922): Any structural anomaly of the hand. Evidence: TAS. (OMIM:122850)
- Dupuytren contracture (HP:0005679): An abnormality of the hand resulting from contracture of the palmar fascia with a fixed flexion deformity of the metacarpophalangeal (MCP) joints and the proximal interphalangeal (PIP) joints. Evidence: IEA. (OMIM:122850)